Phenotypes associated with the disease Small cell carcinoma of the bladder (ORPHA:284400):
- Hematuria (HP:0000790): The presence of blood in the urine. Hematuria may be gross hematuria (visible to the naked eye) or microscopic hematuria (detected by dipstick or microscopic examination of the urine). Evidence: TAS. Frequency: Very frequent (HP:0040281). (ORPHA:284400)
- Abdominal pain (HP:0002027): An unpleasant sensation characterized by physical discomfort (such as pricking, throbbing, or aching) and perceived to originate in the abdomen. Evidence: TAS. Frequency: Occasional (HP:0040283). (ORPHA:284400)
- Hypercalcemia (HP:0003072): The concentration of calcium in the blood circulation is above the upper limit of normal. Evidence: TAS. Frequency: Occasional (HP:0040283). (ORPHA:284400)
- Bladder neoplasm (HP:0009725): The presence of a neoplasm of the urinary bladder. Evidence: TAS. Frequency: Very frequent (HP:0040281). (ORPHA:284400)
- Dysuria (HP:0100518): Painful or difficult urination. Evidence: TAS. Frequency: Frequent (HP:0040282). (ORPHA:284400)
- Recurrent urinary tract infections (HP:0000010): Repeated infections of the urinary tract. Evidence: TAS. Frequency: Occasional (HP:0040283). (ORPHA:284400)